Phenotypes associated with the disease tooth ankylosis (OMIM:157950):
- Abnormality of the dentition (HP:0000164): Any abnormality of the teeth. Evidence: IEA. (OMIM:157950)
- Clinodactyly of the 5th finger (HP:0004209): Clinodactyly refers to a bending or curvature of the fifth finger in the radial direction (i.e., towards the 4th finger). Evidence: IEA. (OMIM:157950)
- Autosomal dominant inheritance (HP:0000006): A mode of inheritance that is observed for traits related to a gene encoded on one of the autosomes (i.e., the human chromosomes 1-22) in which a trait manifests in heterozygotes. In the context of medical genetics, an autosomal dominant disorder is caused when a single copy of the mutant allele is present. Males and females are affected equally, and can both transmit the disorder with a risk of 50% for each child of inheriting the mutant allele. Evidence: IEA. (OMIM:157950)
- Mandibular prognathia (HP:0000303): Abnormal prominence of the chin related to increased length of the mandible. Evidence: IEA. (OMIM:157950)